- Progressive reticulate hyperpigmentation (HP:0007456). Evidence: TAS. (OMIM:179850)
- Autosomal dominant inheritance (HP:0000006): A mode of inheritance that is observed for traits related to a gene encoded on one of the autosomes (i.e., the human chromosomes 1-22) in which a trait manifests in heterozygotes. In the context of medical genetics, an autosomal dominant disorder is caused when a single copy of the mutant allele is present. Males and females are affected equally, and can both transmit the disorder with a risk of 50% for each child of inheriting the mutant allele. Evidence: TAS. (OMIM:179850)
These phenotypes are associated with the disease Dowling-Degos disease 1 (OMIM:179850).